Phenotypes associated with the disease Atrophoderma vermiculata (ORPHA:79100):
- Atrophic scars (HP:0001075): Scars that form a depression compared to the level of the surrounding skin because of damage to the collagen, fat or other tissues below the skin. Evidence: TAS. Frequency: Very frequent (HP:0040281). (ORPHA:79100)
- Abnormal cheek morphology (HP:0004426): An abnormality of the cheek- one of two bilateral soft tissue facial structures in the region of the face inferior to the eyes and between the nose and the ear. "Buccal" means relating to the cheek. The cheek is part of the midface. Evidence: TAS. Frequency: Very frequent (HP:0040281). (ORPHA:79100)
- Hypoplastic pilosebaceous units (HP:0007515). Evidence: TAS. Frequency: Very frequent (HP:0040281). (ORPHA:79100)
- Abnormal epidermal morphology (HP:0011124): An abnormality of the morphology of the epidermis. Evidence: TAS. Frequency: Very frequent (HP:0040281). (ORPHA:79100)
- Skin pit (HP:0100276): A small, skin-lined tract that leads from the surface to deep within the tissues. Evidence: TAS. Frequency: Very frequent (HP:0040281). (ORPHA:79100)
- Abnormality of the chin (HP:0000306): An abnormality of the chin, i.e., of the inferior portion of the face lying inferior to the lower lip and including the central prominence of the lower jaw. Evidence: TAS. Frequency: Frequent (HP:0040282). (ORPHA:79100)
- Follicular hyperkeratosis (HP:0007502): A skin condition characterized by excessive development of keratin in hair follicles, resulting in rough, cone-shaped, elevated papules resulting from closure of hair follicles with a white plug of sebum. Evidence: TAS. Frequency: Frequent (HP:0040282). (ORPHA:79100)
- Hyperkeratotic papule (HP:0045059): A circumscribed, solid elevation of skin with no visible fluid, varying in size from a pinhead to less than 10mm in diameter at the widest point that is composed of localized hyperkeratosis (the latter may be demonstrated histopathologically). Evidence: TAS. Frequency: Frequent (HP:0040282). (ORPHA:79100)
- Periauricular skin pits (HP:0100277): Benign congenital lesions of the periauricular soft tissue consisting of a blind-ending narrow tube or pit. Evidence: TAS. Frequency: Frequent (HP:0040282). (ORPHA:79100)
- Abnormal forehead morphology (HP:0000290): An anomaly of the forehead. Evidence: TAS. Frequency: Occasional (HP:0040283). (ORPHA:79100)
- Abnormality of the neck (HP:0000464): An abnormality of the neck. Evidence: TAS. Frequency: Occasional (HP:0040283). (ORPHA:79100)
- Atypical behavior (HP:0000708): Atypical behavior is an abnormality in a person's actions that can be controlled or modulated by the will of the individual. While abnormal behaviors can be difficult to control, they are distinct from other abnormal actions that cannot be affected by the individual's will. Evidence: TAS. Frequency: Occasional (HP:0040283). (ORPHA:79100)
- Pruritus (HP:0000989): Pruritus is an itch or a sensation that makes a person want to scratch. This term refers to an abnormally increased disposition to experience pruritus. Evidence: TAS. Frequency: Occasional (HP:0040283). (ORPHA:79100)
- Neurofibroma (HP:0001067): A benign peripheral nerve sheath tumor that generally appears as a soft, skin-colored papule or small subcutaneous nodule. Individuals with neurofibromatosis can have numerous neurofibromas. Evidence: TAS. Frequency: Occasional (HP:0040283). (ORPHA:79100)
- Erythema (HP:0010783): Redness of the skin, caused by hyperemia of the capillaries in the lower layers of the skin. Evidence: TAS. Frequency: Occasional (HP:0040283). (ORPHA:79100)
- Pain (HP:0012531): An unpleasant sensory and emotional experience associated with actual or potential tissue damage, or described in terms of such damage. Evidence: TAS. Frequency: Occasional (HP:0040283). (ORPHA:79100)
- Heart block (HP:0012722): Impaired conduction of cardiac impulse occurring anywhere along the conduction pathway. Evidence: TAS. Frequency: Occasional (HP:0040283). (ORPHA:79100)